Phenotypes associated with the disease pancreatic cancer, susceptibility to, 1 (OMIM:606856):
- Pancreatic adenocarcinoma (HP:0006725): The presence of an adenocarcinoma of the pancreas. Evidence: PCS. (PMID:17194196)
- Autosomal dominant inheritance (HP:0000006): A mode of inheritance that is observed for traits related to a gene encoded on one of the autosomes (i.e., the human chromosomes 1-22) in which a trait manifests in heterozygotes. In the context of medical genetics, an autosomal dominant disorder is caused when a single copy of the mutant allele is present. Males and females are affected equally, and can both transmit the disorder with a risk of 50% for each child of inheriting the mutant allele. Evidence: PCS. (PMID:17194196)